Phenotypes associated with the disease hereditary sensory neuropathy X-linked (OMIM:310470):
- X-linked inheritance (HP:0001417): A mode of inheritance that is observed for traits related to a gene encoded on the X chromosome. Evidence: TAS. (OMIM:310470)
- Decreased number of peripheral myelinated nerve fibers (HP:0003380): A loss of myelinated nerve fibers in the peripheral nervous system (in general, this finding can be observed on nerve biopsy). Evidence: TAS. (OMIM:310470)
- Sensory neuropathy (HP:0000763): Peripheral neuropathy affecting the sensory nerves. Evidence: TAS. (OMIM:310470)